- Increased circulating hemoglobin concentration (HP:0001900): Concentration of hemoglobin in the blood circulation above the upper limit of normal. Evidence: PCS. Frequency: 17/17. (PMID:18818920)
- Increased hematocrit (HP:0001899): An elevation above the normal ratio of the volume of red blood cells to the total volume of blood. Evidence: PCS. Frequency: 17/17. (PMID:18818920)
- Polycythemia (HP:0001901): Polycythemia is diagnosed if the red blood cell count, the hemoglobin level, and the red blood cell volume all exceed the upper limits of normal. Evidence: PCS. Frequency: 17/17. (PMID:18818920)
- Autosomal dominant inheritance (HP:0000006): A mode of inheritance that is observed for traits related to a gene encoded on one of the autosomes (i.e., the human chromosomes 1-22) in which a trait manifests in heterozygotes. In the context of medical genetics, an autosomal dominant disorder is caused when a single copy of the mutant allele is present. Males and females are affected equally, and can both transmit the disorder with a risk of 50% for each child of inheriting the mutant allele. Evidence: PCS. (PMID:18818920)
These phenotypes are associated with the disease erythrocytosis, familial, 6 (OMIM:617980).